- Abnormality of the dentition (HP:0000164): Any abnormality of the teeth. Evidence: PCS. Frequency: 0/14. (PMID:21188418)
- Abnormal nail morphology (HP:0001597): Abnormal structure or appearance of the nail. Evidence: PCS. Frequency: 0/14. (PMID:21188418)
- Childhood onset (HP:0011463): Onset of disease at the age of between 1 and 5 years. Evidence: PCS. Frequency: 14/14. (PMID:21188418)
- Sparse scalp hair (HP:0002209): Decreased number of hairs per unit area of skin of the scalp. Evidence: PCS. Frequency: 14/14. (PMID:21188418)
- Abnormal eyelash morphology (HP:0000499): An abnormality of the eyelashes. Evidence: PCS. Frequency: 0/14. (PMID:21188418)
- Abnormal sweat gland morphology (HP:0000971): Any structural abnormality of the sweat gland. Evidence: PCS. Frequency: 0/14. (PMID:21188418)
- Autosomal dominant inheritance (HP:0000006): A mode of inheritance that is observed for traits related to a gene encoded on one of the autosomes (i.e., the human chromosomes 1-22) in which a trait manifests in heterozygotes. In the context of medical genetics, an autosomal dominant disorder is caused when a single copy of the mutant allele is present. Males and females are affected equally, and can both transmit the disorder with a risk of 50% for each child of inheriting the mutant allele. Evidence: PCS. (PMID:21188418)
These phenotypes are associated with the disease hypotrichosis 3 (OMIM:613981).